- Middle age onset (HP:0003596): A type of adult onset with onset of symptoms at the age of 40 to 60 years. Evidence: PCS. Frequency: 3/3. (PMID:23348765)
- Atrial fibrillation (HP:0005110): An atrial arrhythmia characterized by disorganized atrial activity without discrete P waves on the surface EKG, but instead by an undulating baseline or more sharply circumscribed atrial deflections of varying amplitude an frequency ranging from 350 to 600 per minute. Evidence: PCS. Frequency: 21/21. (PMID:23348765;PMID:20818502;PMID:20650941)
- Reduced left ventricular ejection fraction (HP:0012664): A diminution of the volumetric fraction of blood pumped out of the ventricle with each cardiac cycle. Evidence: PCS. Frequency: 0/2. (PMID:23348765)
- Prolonged QRS complex (HP:0006677): Increased time for the complex comprised of the Q wave, R wave, and S wave as measured by the electrocardiogram (EKG).. In adults, normal values are 0.06 - 0.10 sec. Evidence: PCS. Frequency: 1/3. (PMID:23348765)
- Autosomal dominant inheritance (HP:0000006): A mode of inheritance that is observed for traits related to a gene encoded on one of the autosomes (i.e., the human chromosomes 1-22) in which a trait manifests in heterozygotes. In the context of medical genetics, an autosomal dominant disorder is caused when a single copy of the mutant allele is present. Males and females are affected equally, and can both transmit the disorder with a risk of 50% for each child of inheriting the mutant allele. Evidence: PCS. (PMID:20818502)
- Prolonged P wave (HP:0034308): Abnormal increased in the duration of the P wave, which is a marker of delayed inter-atrial conduction. Evidence: PCS. Frequency: 1/1. (PMID:23348765)
These phenotypes are associated with the disease atrial fibrillation, familial, 11 (OMIM:614049).